- Split hand (HP:0001171): A condition in which middle parts of the hand (fingers and metacarpals) are missing giving a cleft appearance. The severity is very variable ranging from slightly hypoplastic middle fingers over absent middle fingers as far as oligo- or monodactyl hands. Evidence: TAS. Frequency: Very frequent (HP:0040281). (ORPHA:1122)
- Split foot (HP:0001839): A condition in which middle parts of the foot (toes and metatarsals) are missing giving a cleft appearance. The severity is very variable ranging from slightly hypoplastic 3rd toe over absent 2nd or 3rd toes as far as oligo- or monodactyl feet. Evidence: TAS. Frequency: Frequent (HP:0040282). (ORPHA:1122)
- Hypoplasia of the ulna (HP:0003022): Underdevelopment of the ulna. Evidence: TAS. Frequency: Very frequent (HP:0040281). (ORPHA:1122)
- Aplasia/Hypoplasia of the radius (HP:0006501): A small/hypoplastic or absent/aplastic radius. Evidence: TAS. Frequency: Very frequent (HP:0040281). (ORPHA:1122)
These phenotypes are associated with the disease Ulnar hypoplasia-split foot syndrome (ORPHA:1122).